- Subcutaneous nodule (HP:0001482): Slightly elevated lesions on or in the skin with a diameter of over 5 mm. Evidence: TAS. Frequency: Very frequent (HP:0040281). (ORPHA:99971)
- Gastrointestinal dysmotility (HP:0002579): Abnormal intestinal contractions, such as spasms and intestinal paralysis, related to the loss of the ability of the gut to coordinate muscular activity because of endogenous or exogenous causes. Evidence: TAS. Frequency: Occasional (HP:0040283). (ORPHA:99971)
- Abnormal renal physiology (HP:0012211): An abnormal functionality of the kidney. Evidence: TAS. Frequency: Occasional (HP:0040283). (ORPHA:99971)
These phenotypes are associated with the disease Well-differentiated liposarcoma (ORPHA:99971).